- Autosomal dominant inheritance (HP:0000006): A mode of inheritance that is observed for traits related to a gene encoded on one of the autosomes (i.e., the human chromosomes 1-22) in which a trait manifests in heterozygotes. In the context of medical genetics, an autosomal dominant disorder is caused when a single copy of the mutant allele is present. Males and females are affected equally, and can both transmit the disorder with a risk of 50% for each child of inheriting the mutant allele. Evidence: TAS. (OMIM:120300)
- Macular pseudocoloboma (HP:0001116): A so-called macular coloboma is characterized by a sharply defined, usually excavated, area without neuroretina and RPE tissues in the central area of the fundus. This lesion is not related to classical colobomas associated with optic fissure closure defects. Evidence: TAS. (OMIM:120300)
These phenotypes are associated with the disease coloboma of macula (OMIM:120300).